- Radial bowing (HP:0002986): A bending or abnormal curvature of the radius. Evidence: TAS. Frequency: Very frequent (HP:0040281). (ORPHA:2497)
- Hypoplasia of the ulna (HP:0003022): Underdevelopment of the ulna. Evidence: TAS. Frequency: Very frequent (HP:0040281). (ORPHA:2497)
- Ulnar deviation of finger (HP:0009465): Bending or curvature of a finger toward the ulnar side (i.e., away from the thumb). The deviation is at the metacarpal-phalangeal joint, and this finding is distinct from clinodactyly. Evidence: TAS. Frequency: Very frequent (HP:0040281). (ORPHA:2497)
These phenotypes are associated with the disease Upper limb mesomelic dysplasia, type Fryns (ORPHA:2497).